- Intrauterine growth retardation (HP:0001511): An abnormal restriction of fetal growth with fetal weight below the tenth percentile for gestational age. Evidence: TAS. Frequency: Frequent (HP:0040282). (ORPHA:1327)
- Toe syndactyly (HP:0001770): Webbing or fusion of the toes, involving soft parts only or including bone structure. Bony fusions are referred to as "bony" Syndactyly if the fusion occurs in a radio-ulnar axis. Fusions of bones of the toes in a proximo-distal axis are referred to as "Symphalangism". Evidence: TAS. Frequency: Frequent (HP:0040282). (ORPHA:1327)
- Hallux valgus (HP:0001822): Lateral deviation of the great toe (i.e., in the direction of the little toe). Evidence: TAS. Frequency: Frequent (HP:0040282). (ORPHA:1327)
- Short toe (HP:0001831): A toe that appears disproportionately short compared to the foot. Evidence: TAS. Frequency: Frequent (HP:0040282). (ORPHA:1327)
- Spina bifida (HP:0002414): Incomplete closure of the embryonic neural tube, whereby some vertebral arches remain unfused and open. The mildest form is spina bifida occulta, followed by meningocele and meningomyelocele. Evidence: TAS. Frequency: Frequent (HP:0040282). (ORPHA:1327)
- Downturned corners of mouth (HP:0002714): A morphological abnormality of the mouth in which the angle of the mouth is downturned. The oral commissures are positioned inferior to the midline labial fissure. Evidence: TAS. Frequency: Frequent (HP:0040282). (ORPHA:1327)
- Delayed skeletal maturation (HP:0002750): A decreased rate of skeletal maturation. Delayed skeletal maturation can be diagnosed on the basis of an estimation of the bone age from radiographs of specific bones in the human body. Evidence: TAS. Frequency: Frequent (HP:0040282). (ORPHA:1327)
- Cubitus valgus (HP:0002967): Abnormal positioning in which the elbows are turned out. Evidence: TAS. Frequency: Frequent (HP:0040282). (ORPHA:1327)
- Short nose (HP:0003196): Distance from nasion to subnasale more than two standard deviations below the mean, or alternatively, an apparently decreased length from the nasal root to the nasal tip. Evidence: TAS. Frequency: Frequent (HP:0040282). (ORPHA:1327)
- Scapular winging (HP:0003691): Abnormal protrusion of the scapula away from the surface of the back. Evidence: TAS. Frequency: Frequent (HP:0040282). (ORPHA:1327)
- Short stature (HP:0004322): A height below that which is expected according to age and gender norms. Although there is no universally accepted definition of short stature, many refer to "short stature" as height more than 2 standard deviations below the mean for age and gender (or below the 3rd percentile for age and gender dependent norms). Evidence: TAS. Frequency: Frequent (HP:0040282). (ORPHA:1327)
- Depressed nasal bridge (HP:0005280): Posterior positioning of the nasal root in relation to the overall facial profile for age. Evidence: TAS. Frequency: Frequent (HP:0040282). (ORPHA:1327)
- Underdeveloped supraorbital ridges (HP:0009891): Flatness of the supraorbital portion of the frontal bones. Evidence: TAS. Frequency: Frequent (HP:0040282). (ORPHA:1327)
- Long face (HP:0000276): Facial height (length) is more than 2 standard deviations above the mean (objective); or, an apparent increase in the height (length) of the face (subjective). Evidence: TAS. Frequency: Occasional (HP:0040283). (ORPHA:1327)
- Blepharophimosis (HP:0000581): A fixed reduction in the vertical distance between the upper and lower eyelids with short palpebral fissures. Evidence: TAS. Frequency: Occasional (HP:0040283). (ORPHA:1327)
- Synophrys (HP:0000664): Meeting of the medial eyebrows in the midline. Evidence: TAS. Frequency: Occasional (HP:0040283). (ORPHA:1327)
- Sacral dimple (HP:0000960): A cutaneous indentation resulting from tethering of the skin to underlying structures (bone) of the intergluteal cleft. Evidence: TAS. Frequency: Occasional (HP:0040283). (ORPHA:1327)
- Highly arched eyebrow (HP:0002553): Increased height of the central portion of the eyebrow, forming a crescent, semicircular, or inverted U shape. Evidence: TAS. Frequency: Occasional (HP:0040283). (ORPHA:1327)
- Short distal phalanx of finger (HP:0009882): Short distance from the end of the finger to the most distal interphalangeal crease or the distal interphalangeal joint flexion point. That is, hypoplasia of one or more of the distal phalanx of finger. Evidence: TAS. Frequency: Occasional (HP:0040283). (ORPHA:1327)
- Posteriorly rotated ears (HP:0000358): A type of abnormal location of the ears in which the position of the ears is characterized by posterior rotation (the superior part of the ears is rotated towards the back of the head, and the inferior part of the ears towards the front). Evidence: TAS. Frequency: Occasional (HP:0040283). (ORPHA:1327)
- Telecanthus (HP:0000506): Distance between the inner canthi more than two standard deviations above the mean (objective); or, apparently increased distance between the inner canthi. Evidence: TAS. Frequency: Very frequent (HP:0040281). (ORPHA:1327)
- Dental malocclusion (HP:0000689): Dental malocclusion refers to an abnormality of the occlusion, or alignment, of the teeth and the way the upper and lower teeth fit together, resulting in overcrowding of teeth or in abnormal bite patterns. Evidence: TAS. Frequency: Very frequent (HP:0040281). (ORPHA:1327)
- Pectus excavatum (HP:0000767): A defect of the chest wall characterized by a depression of the sternum, giving the chest ("pectus") a caved-in ("excavatum") appearance. Evidence: TAS. Frequency: Very frequent (HP:0040281). (ORPHA:1327)
- Pectus carinatum (HP:0000768): A deformity of the chest caused by overgrowth of the ribs and characterized by protrusion of the sternum. Evidence: TAS. Frequency: Very frequent (HP:0040281). (ORPHA:1327)
- Abnormal vertebral body morphology (HP:0003312): Abnormal form of vertebral body, which is the central cylindrical portion of the vertebra that together with other structures such as the vertebral arch, pedicles, laminae, spinous process, transverse processes, and articular facets makes up a vertebra. Evidence: TAS. Frequency: Very frequent (HP:0040281). (ORPHA:1327)
- Abnormality of dental eruption (HP:0006292): An abnormality of tooth eruption. Evidence: TAS. Frequency: Very frequent (HP:0040281). (ORPHA:1327)
- Microtia (HP:0008551): Underdevelopment of the external ear. Evidence: TAS. Frequency: Very frequent (HP:0040281). (ORPHA:1327)
- Attached earlobe (HP:0009907): Attachment of the lobe to the side of the face at the lowest point of the lobe without curving upward. Evidence: TAS. Frequency: Very frequent (HP:0040281). (ORPHA:1327)
- Open bite (HP:0010807): Visible space between the dental arches in occlusion. Evidence: TAS. Frequency: Very frequent (HP:0040281). (ORPHA:1327)
- Midface retrusion (HP:0011800): Posterior positions and/or vertical shortening of the infraorbital and perialar regions, or increased concavity of the face and/or reduced nasolabial angle. Evidence: TAS. Frequency: Very frequent (HP:0040281). (ORPHA:1327)
- Flat face (HP:0012368): Absence of concavity or convexity of the face when viewed in profile. Evidence: TAS. Frequency: Very frequent (HP:0040281). (ORPHA:1327)
- Camptodactyly of finger (HP:0100490): The distal interphalangeal joint and/or the proximal interphalangeal joint of the fingers cannot be extended to 180 degrees by either active or passive extension. Evidence: TAS. Frequency: Very frequent (HP:0040281). (ORPHA:1327)
- Narrow mouth (HP:0000160): Distance between the commissures of the mouth more than 2 SD below the mean. Alternatively, an apparently decreased width of the oral aperture (subjective). Evidence: TAS. Frequency: Frequent (HP:0040282). (ORPHA:1327)
- High palate (HP:0000218): Height of the palate more than 2 SD above the mean (objective) or palatal height at the level of the first permanent molar more than twice the height of the teeth (subjective). Evidence: TAS. Frequency: Frequent (HP:0040282). (ORPHA:1327)
- Brachycephaly (HP:0000248): An abnormality of skull shape characterized by a decreased anterior-posterior diameter. That is, a cephalic index greater than 81%. Alternatively, an apparently shortened anteroposterior dimension (length) of the head compared to width. Evidence: TAS. Frequency: Frequent (HP:0040282). (ORPHA:1327)
- Microcephaly (HP:0000252): Head circumference below 2 standard deviations below the mean for age and gender. Evidence: TAS. Frequency: Frequent (HP:0040282). (ORPHA:1327)
- Narrow face (HP:0000275): Bizygomatic (upper face) and bigonial (lower face) width are both more than 2 standard deviations below the mean (objective); or, an apparent reduction in the width of the upper and lower face (subjective). Evidence: TAS. Frequency: Frequent (HP:0040282). (ORPHA:1327)
- Epicanthus (HP:0000286): A fold of skin starting above the medial aspect of the upper eyelid and arching downward to cover, pass in front of and lateral to the medial canthus. Evidence: TAS. Frequency: Frequent (HP:0040282). (ORPHA:1327)
- Mandibular prognathia (HP:0000303): Abnormal prominence of the chin related to increased length of the mandible. Evidence: TAS. Frequency: Frequent (HP:0040282). (ORPHA:1327)
- Anteverted nares (HP:0000463): Anteriorly-facing nostrils viewed with the head in the Frankfurt horizontal and the eyes of the observer level with the eyes of the subject. This gives the appearance of an upturned nose (upturned nasal tip). Evidence: TAS. Frequency: Frequent (HP:0040282). (ORPHA:1327)
- Microcornea (HP:0000482): A congenital abnormality of the cornea in which the cornea and the anterior segment of the eye are smaller than normal. The horizontal diameter of the cornea does not reach 10 mm even in adulthood. Evidence: TAS. Frequency: Frequent (HP:0040282). (ORPHA:1327)
- Narrow chest (HP:0000774): Reduced width of the chest from side to side, associated with a reduced distance from the sternal notch to the tip of the shoulder. Evidence: TAS. Frequency: Frequent (HP:0040282). (ORPHA:1327)
- Melanocytic nevus (HP:0000995): A oval and round, colored (usually medium-to dark brown, reddish brown, or flesh colored) lesion. Typically, a melanocytic nevus is less than 6 mm in diameter, but may be much smaller or larger. Evidence: TAS. Frequency: Frequent (HP:0040282). (ORPHA:1327)
- Brachydactyly (HP:0001156): Digits that appear disproportionately short compared to the hand/foot. The word brachydactyly is used here to describe a series distinct patterns of shortened digits (brachydactyly types A-E). This is the sense used here. Evidence: TAS. Frequency: Frequent (HP:0040282). (ORPHA:1327)
- Intellectual disability (HP:0001249): The term intellectual disability or intellectual developmental disorder is used to describe significantly sub-average intellectual and adaptive functioning based on clinical assessment and as measured by individually administered, appropriately normed, standardized and validated tests of intellectual functioning and adaptive behavior, with onset during the developmental period from infancy through adolescence. Evidence: TAS. Frequency: Frequent (HP:0040282). (ORPHA:1327)
- Seizure (HP:0001250): A seizure is an intermittent abnormality of nervous system physiology characterized by a transient occurrence of signs and/or symptoms due to abnormal excessive or synchronous neuronal activity in the brain. Evidence: TAS. Frequency: Frequent (HP:0040282). (ORPHA:1327)
- Global developmental delay (HP:0001263): A delay in the achievement of motor or mental milestones in the domains of development of a child, including motor skills, speech and language, cognitive skills, and social and emotional skills. This term should only be used to describe children younger than five years of age. Evidence: TAS. Frequency: Frequent (HP:0040282). (ORPHA:1327)
These phenotypes are associated with the disease Camptodactyly syndrome, Guadalajara type 1 (ORPHA:1327).